- Juvenile onset (HP:0003621): Onset of signs or symptoms of disease between the age of 5 and 15 years. Evidence: TAS. (OMIM:103900)
- Abnormality of the urinary system (HP:0000079): An abnormality of the urinary system. Evidence: IEA. (OMIM:103900)
- Increased circulating aldosterone concentration (HP:0000859): Overproduction of the mineralocorticoid aldosterone by the adrenal cortex. Evidence: IEA. (OMIM:103900)
- Childhood onset (HP:0011463): Onset of disease at the age of between 1 and 5 years. Evidence: TAS. (OMIM:103900)
- Adult onset (HP:0003581): Onset of disease manifestations in adulthood, defined here as at the age of 16 years or later. Evidence: TAS. (OMIM:103900)
- Decreased circulating renin concentration (HP:0003351): An decreased level of renin in the blood. Evidence: IEA. (OMIM:103900)
- Adrenal hyperplasia (HP:0008221): Enlargement of the adrenal gland. Evidence: IEA. (OMIM:103900)
- Hypertension (HP:0000822): The presence of chronic increased pressure in the systemic arterial system. Evidence: IEA. (OMIM:103900)
- Adrenogenital syndrome (HP:0000840): Adrenogenital syndrome is also known as congenital adrenal hyperplasia, which results from disorders of steroid hormone production in the adrenal glands leading to a deficiency of cortisol. The pituitary gland reacts by increased secretion of corticotropin, which in turn causes the adrenal glands to overproduce certain intermediary hormones which have testosterone-like effects. Evidence: IEA. (OMIM:103900)
- Autosomal dominant inheritance (HP:0000006): A mode of inheritance that is observed for traits related to a gene encoded on one of the autosomes (i.e., the human chromosomes 1-22) in which a trait manifests in heterozygotes. In the context of medical genetics, an autosomal dominant disorder is caused when a single copy of the mutant allele is present. Males and females are affected equally, and can both transmit the disorder with a risk of 50% for each child of inheriting the mutant allele. Evidence: IEA. (OMIM:103900)
These phenotypes are associated with the disease glucocorticoid-remediable aldosteronism (OMIM:103900).